Phenotypes associated with the disease hyperphosphatasia with intellectual disability syndrome 5 (OMIM:616025):
- Tented upper lip vermilion (HP:0010804): Triangular appearance of the oral aperture with the apex in the midpoint of the upper vermilion and the lower vermilion forming the base. Evidence: PCS. Frequency: 2/2. (PMID:24367057;PMID:30813920)
- Hypsarrhythmia (HP:0002521): Hypsarrhythmia is abnormal interictal high amplitude waves and a background of irregular spikes. There is continuous (during wakefulness), high-amplitude (>200 Hz), generalized polymorphic slowing with no organized background and multifocal spikes demonstrated by electroencephalography (EEG). Evidence: PCS. Frequency: 1/1. (PMID:24367057)
- Wide nasal bridge (HP:0000431): Increased breadth of the nasal bridge (and with it, the nasal root). Evidence: PCS. Frequency: 2/2. (PMID:24367057;PMID:30813920)
- Absent speech (HP:0001344): Complete lack of development of speech and language abilities. Evidence: IEA. (OMIM:616025)
- Inguinal hernia (HP:0000023): Protrusion of the contents of the abdominal cavity through the inguinal canal. Evidence: PCS. Frequency: 1/1. (PMID:30813920)
- Seizure (HP:0001250): A seizure is an intermittent abnormality of nervous system physiology characterized by a transient occurrence of signs and/or symptoms due to abnormal excessive or synchronous neuronal activity in the brain. Evidence: IEA. (OMIM:616025)
- Elevated circulating alkaline phosphatase concentration (HP:0003155): Abnormally increased serum levels of alkaline phosphatase activity. Evidence: PCS. Frequency: 1/1. (PMID:24367057)
- Global developmental delay (HP:0001263): A delay in the achievement of motor or mental milestones in the domains of development of a child, including motor skills, speech and language, cognitive skills, and social and emotional skills. This term should only be used to describe children younger than five years of age. Evidence: TAS. (OMIM:616025)
- Infantile onset (HP:0003593): Onset of signs or symptoms of disease between 28 days to one year of life. Evidence: PCS. Frequency: 1/1. (PMID:30813920)
- Profound global developmental delay (HP:0012736): A profound delay in the achievement of motor or mental milestones in the domains of development of a child. Evidence: PCS. Frequency: 1/1. (PMID:24367057)
- Coarse facial features (HP:0000280): Absence of fine and sharp appearance of brows, nose, lips, mouth, and chin, usually because of rounded and heavy features or thickened skin with or without thickening of subcutaneous and bony tissues. Evidence: PCS. Frequency: 1/1. (PMID:30813920)
- Widened subarachnoid space (HP:0012704): An increase in size of the anatomic space between the arachnoid membrane and pia mater. Evidence: PCS. Frequency: 1/1. (PMID:30813920)
- Severe global developmental delay (HP:0011344): A severe delay in the achievement of motor or mental milestones in the domains of development of a child. Evidence: PCS. Frequency: 1/1. (PMID:30813920)
- Tonic seizure (HP:0032792): A tonic seizure is a type of motor seizure characterized by unilateral or bilateral limb stiffening or elevation, often with neck stiffening. Evidence: PCS. Frequency: 1/1. (PMID:24367057)
- Umbilical hernia (HP:0001537): Protrusion of abdominal contents through a defect in the abdominal wall musculature around the umbilicus. Skin and subcutaneous tissue overlie the defect. Evidence: PCS. Frequency: 1/1. (PMID:30813920)
- Autosomal recessive inheritance (HP:0000007): A mode of inheritance that is observed for traits related to a gene encoded on one of the autosomes (i.e., the human chromosomes 1-22) in which a trait manifests in individuals with two pathogenic alleles, either homozygotes (two copies of the same mutant allele) or compound heterozygotes (whereby each copy of a gene has a distinct mutant allele). Evidence: PCS. (PMID:24367057)
- High palate (HP:0000218): Height of the palate more than 2 SD above the mean (objective) or palatal height at the level of the first permanent molar more than twice the height of the teeth (subjective). Evidence: PCS. Frequency: 1/1. (PMID:30813920)
- Macroglossia (HP:0000158): Increased length and width of the tongue. Evidence: IEA. (OMIM:616025)
- Focal-onset seizure (HP:0007359): A focal-onset seizure is a type of seizure originating within networks limited to one hemisphere. They may be discretely localized or more widely distributed, and may originate in subcortical structures. Evidence: PCS. Frequency: 1/1. (PMID:30813920)
- Intellectual disability (HP:0001249): The term intellectual disability or intellectual developmental disorder is used to describe significantly sub-average intellectual and adaptive functioning based on clinical assessment and as measured by individually administered, appropriately normed, standardized and validated tests of intellectual functioning and adaptive behavior, with onset during the developmental period from infancy through adolescence. Evidence: IEA. (OMIM:616025)